- Vomiting (HP:0002013): Forceful ejection of the contents of the stomach through the mouth by means of a series of involuntary spasmic contractions. Evidence: IEA. (OMIM:607508)
- Migraine with aura (HP:0002077): A type of migraine in which there is an aura characterized by focal neurological phenomena that usually proceed, but may accompany or occur in the absence of, the headache. The symptoms of an aura may include fully reversible visual, sensory, and speech symptoms but not motor weakness. Visual symptoms may include flickering lights, spots and lines and/or loss of vision and/or unilateral sensory symptoms such as paresthesias or numbness. At least one of the symptoms of an aura develops gradually over 5 or more minutes and/or different symptoms occur in succession. Evidence: IEA. (OMIM:607508)
- Photophobia (HP:0000613): Excessive sensitivity to light with the sensation of discomfort or pain in the eyes due to exposure to bright light. Evidence: IEA. (OMIM:607508)
- Migraine without aura (HP:0002083): Repeated headache attacks lasting 4-72 h fulfilling at least two of the following criteria: 1) unilateral location, 2) pulsating quality, 3) moderate or severe pain intensity, and 4) aggravation by or causing avoidance of routine physical activity such as climbing stairs. Headache attacks are commonly accompanied by nausea, vomiting, photophobia, or phonophobia. Evidence: IEA. (OMIM:607508)
- Phonophobia (HP:0002183): An abnormally heightened sensitivity to loud sounds. Evidence: IEA. (OMIM:607508)
- Nausea (HP:0002018): A sensation of unease in the stomach together with an urge to vomit. Evidence: IEA. (OMIM:607508)
- Autosomal dominant inheritance (HP:0000006): A mode of inheritance that is observed for traits related to a gene encoded on one of the autosomes (i.e., the human chromosomes 1-22) in which a trait manifests in heterozygotes. In the context of medical genetics, an autosomal dominant disorder is caused when a single copy of the mutant allele is present. Males and females are affected equally, and can both transmit the disorder with a risk of 50% for each child of inheriting the mutant allele. Evidence: IEA. (OMIM:607508)
These phenotypes are associated with the disease migraine with or without aura, susceptibility to, 5 (OMIM:607508).